- Abnormal abdomen morphology (HP:0001438): A structural abnormality of the abdomen ('belly'), that is, the part of the body between the pelvis and the thorax. Evidence: IEA. (OMIM:601228)
- Autosomal dominant inheritance (HP:0000006): A mode of inheritance that is observed for traits related to a gene encoded on one of the autosomes (i.e., the human chromosomes 1-22) in which a trait manifests in heterozygotes. In the context of medical genetics, an autosomal dominant disorder is caused when a single copy of the mutant allele is present. Males and females are affected equally, and can both transmit the disorder with a risk of 50% for each child of inheriting the mutant allele. Evidence: IEA. (OMIM:601228)
These phenotypes are associated with the disease polyposis syndrome, hereditary mixed, 1 (OMIM:601228).